- Abnormal cerebellum morphology (HP:0001317): Any structural abnormality of the cerebellum. Evidence: IEA. (OMIM:602197)
This phenotype is associated with the disease Cerebellar degeneration-related autoantigen 3 (OMIM:602197).